- Hearing impairment (HP:0000365): A decreased magnitude of the sensory perception of sound. Evidence: PCS. (PMID:34050020)
- Late onset (HP:0003584): A type of adult onset with onset of symptoms after the age of 60 years. Evidence: PCS. (PMID:34050020)
- Autosomal dominant inheritance (HP:0000006): A mode of inheritance that is observed for traits related to a gene encoded on one of the autosomes (i.e., the human chromosomes 1-22) in which a trait manifests in heterozygotes. In the context of medical genetics, an autosomal dominant disorder is caused when a single copy of the mutant allele is present. Males and females are affected equally, and can both transmit the disorder with a risk of 50% for each child of inheriting the mutant allele. Evidence: PCS. (PMID:34050020)
- Abnormal speech discrimination (HP:0001963): A type of hearing impairment prominently characterized by a difficulty in understanding speech, rather than an inability to hear speech. Poor speech discrimination is a very common symptom of high frequency hearing loss. Evidence: PCS. (PMID:34050020)
These phenotypes are associated with the disease auditory neuropathy, autosomal dominant 3 (OMIM:619832).